Phenotypes associated with the disease hearing loss, autosomal recessive 115 (OMIM:618457):
- Sensorineural hearing impairment (HP:0000407): A type of hearing impairment in one or both ears related to an abnormal functionality of the cochlear nerve. Evidence: PCS. Frequency: 1/1. (PMID:30973865)
- Autosomal recessive inheritance (HP:0000007): A mode of inheritance that is observed for traits related to a gene encoded on one of the autosomes (i.e., the human chromosomes 1-22) in which a trait manifests in individuals with two pathogenic alleles, either homozygotes (two copies of the same mutant allele) or compound heterozygotes (whereby each copy of a gene has a distinct mutant allele). Evidence: PCS. (PMID:30973865)